- Progressive (HP:0003676): Applies to a disease manifestation that increases in scope or severity over the course of time, i.e., that worsens with age. Evidence: IEA. (OMIM:605280)
- Impaired vibration sensation in the lower limbs (HP:0002166): A decrease in the ability to perceive vibration in the legs. Evidence: IEA. (OMIM:605280)
- Urinary urgency (HP:0000012): Urge incontinence is the strong, sudden need to urinate. Evidence: IEA. (OMIM:605280)
- Babinski sign (HP:0003487): Upturning of the big toe (and sometimes fanning of the other toes) in response to stimulation of the sole of the foot. If the Babinski sign is present it can indicate damage to the corticospinal tract. Evidence: IEA. (OMIM:605280)
- Lower limb muscle weakness (HP:0007340): Weakness of the muscles of the legs. Evidence: IEA. (OMIM:605280)
- Urinary incontinence (HP:0000020): Loss of the ability to control the urinary bladder leading to involuntary urination. Evidence: IEA. (OMIM:605280)
- Spastic gait (HP:0002064): Spasticity is manifested by increased stretch reflex which is intensified with movement velocity. This results in excessive and inappropriate muscle activation which can contribute to muscle hypertonia. Spastic gait is characterized by manifestations such as muscle hypertonia, stiff knee, and circumduction of the leg. Evidence: IEA. (OMIM:605280)
- Urinary bladder sphincter dysfunction (HP:0002839): Abnormal function of a sphincter of the urinary bladder. Evidence: IEA. (OMIM:605280)
- Lower limb spasticity (HP:0002061): Spasticity (velocity-dependent increase in tonic stretch reflexes with increased muscle tone and hyperexcitable tendon reflexes) in the muscles of the lower limbs, hips, and pelvis. Evidence: IEA. (OMIM:605280)
- Spastic paraplegia (HP:0001258): Complete loss of the ability to move the lower limbs accompanied by spasticity of the lower limbs. Evidence: TAS. (OMIM:605280)
- Autosomal dominant inheritance (HP:0000006): A mode of inheritance that is observed for traits related to a gene encoded on one of the autosomes (i.e., the human chromosomes 1-22) in which a trait manifests in heterozygotes. In the context of medical genetics, an autosomal dominant disorder is caused when a single copy of the mutant allele is present. Males and females are affected equally, and can both transmit the disorder with a risk of 50% for each child of inheriting the mutant allele. Evidence: IEA. (OMIM:605280)
- Hyperreflexia (HP:0001347): Hyperreflexia is the presence of hyperactive stretch reflexes of the muscles. Evidence: IEA. (OMIM:605280)
These phenotypes are associated with the disease hereditary spastic paraplegia 13 (OMIM:605280).